Phenotypes associated with the disease Mycetoma (ORPHA:2583):
- Prominent superficial veins (HP:0001015): A condition in which superficial veins (i.e., veins just under the skin) are more conspicuous or noticeable than normal. Evidence: TAS. Frequency: Frequent (HP:0040282). (ORPHA:2583)
- Subcutaneous nodule (HP:0001482): Slightly elevated lesions on or in the skin with a diameter of over 5 mm. Evidence: TAS. Frequency: Frequent (HP:0040282). (ORPHA:2583)
- Recurrent fungal infections (HP:0002841): Increased susceptibility to fungal infections as manifested by multiple episodes of fungal infection. Evidence: TAS. Frequency: Frequent (HP:0040282). (ORPHA:2583)
- Abnormal bone structure (HP:0003330): Any anomaly in the composite material or the layered arrangement of the bony skeleton. Evidence: TAS. Frequency: Frequent (HP:0040282). (ORPHA:2583)
- Recurrent bacterial skin infections (HP:0005406): Increased susceptibility to bacterial infections of the skin, as manifested by recurrent episodes of infectious dermatitis. Evidence: TAS. Frequency: Frequent (HP:0040282). (ORPHA:2583)
- Structural foot deformity (HP:0010219): A foot deformity resulting due to an abnormality affecting the bones of the foot (as well as muscle and soft tissue). In contrast if only the muscle and soft tissue are affected the term positional foot deformity applies. Evidence: TAS. Frequency: Frequent (HP:0040282). (ORPHA:2583)
- Stiff skin (HP:0030053): An induration (hardening) of the skin. Evidence: TAS. Frequency: Frequent (HP:0040282). (ORPHA:2583)
- Cobblestone-like hyperkeratosis (HP:0031288): The presence of verrucous, cobblestone-like papules and nodules in a region of skin that is said to have an appearance like that of cobblestones. Evidence: TAS. Frequency: Frequent (HP:0040282). (ORPHA:2583)
- Osteoporosis (HP:0000939): Osteoporosis is a systemic skeletal disease characterized by low bone density and microarchitectural deterioration of bone tissue with a consequent increase in bone fragility. According to the WHO criteria, osteoporosis is defined as a BMD that lies 2.5 standard deviations or more below the average value for young healthy adults (a T-score below -2.5 SD). Evidence: TAS. Frequency: Occasional (HP:0040283). (ORPHA:2583)
- Abnormality of the hand (HP:0001155): An abnormality affecting one or both hands. Evidence: TAS. Frequency: Occasional (HP:0040283). (ORPHA:2583)
- Osteomyelitis (HP:0002754): Osteomyelitis is an inflammatory process accompanied by bone destruction and caused by an infecting microorganism. Evidence: TAS. Frequency: Occasional (HP:0040283). (ORPHA:2583)
- Abnormality of the knee (HP:0002815): An abnormality of the knee joint or surrounding structures. Evidence: TAS. Frequency: Occasional (HP:0040283). (ORPHA:2583)
- Abnormal appendicular skeleton morphology (HP:0011844): An abnormality of the appendicular skeletal system, consisting of the of the limbs, shoulder and pelvic girdles. Evidence: TAS. Frequency: Occasional (HP:0040283). (ORPHA:2583)
- Cutaneous cyst (HP:0025245): A hollow mass located in the skin that is surrounded by an epithelium-lined wall and is well demarcated from the adjacent tissue. Cysts are often said to be sac-like and may contain serous liquid or semisolid material. Evidence: TAS. Frequency: Occasional (HP:0040283). (ORPHA:2583)
- Abnormal forearm bone morphology (HP:0040072). Evidence: TAS. Frequency: Occasional (HP:0040283). (ORPHA:2583)
- Abnormality of the lymphatic system (HP:0100763): An anomaly of the lymphatic system, a network of lymphatic vessels that carry a clear fluid called lymph unidirectionally towards either the right lymphatic duct or the thoracic duct, which in turn drain into the right and left subclavian veins respectively. Evidence: TAS. Frequency: Occasional (HP:0040283). (ORPHA:2583)
- Abnormality of head or neck (HP:0000152): An abnormality of head and neck. Evidence: TAS. Frequency: Very rare (HP:0040284). (ORPHA:2583)
- Abnormality of the nervous system (HP:0000707): An abnormality of the nervous system. Evidence: TAS. Frequency: Very rare (HP:0040284). (ORPHA:2583)
- Abnormal thorax morphology (HP:0000765): Any abnormality of the thorax (the region of the body formed by the sternum, the thoracic vertebrae and the ribs). Evidence: TAS. Frequency: Very rare (HP:0040284). (ORPHA:2583)
- Painless fractures due to injury (HP:0002661): An increased tendency to fractures following trauma, with fractures occurring without pain. Evidence: TAS. Frequency: Very rare (HP:0040284). (ORPHA:2583)
- Pathologic fracture (HP:0002756): A pathologic fracture occurs when a bone breaks in an area that is weakened secondarily to another disease process such as tumor, infection, and certain inherited bone disorders. A pathologic fracture can occur without a degree of trauma required to cause fracture in healthy bone. Evidence: TAS. Frequency: Very rare (HP:0040284). (ORPHA:2583)
- Vertebral compression fracture (HP:0002953). Evidence: TAS. Frequency: Very rare (HP:0040284). (ORPHA:2583)
- Abnormal vertebral body morphology (HP:0003312): Abnormal form of vertebral body, which is the central cylindrical portion of the vertebra that together with other structures such as the vertebral arch, pedicles, laminae, spinous process, transverse processes, and articular facets makes up a vertebra. Evidence: TAS. Frequency: Very rare (HP:0040284). (ORPHA:2583)
- Back pain (HP:0003418): An unpleasant sensation characterized by physical discomfort (such as pricking, throbbing, or aching) localized to the back. Evidence: TAS. Frequency: Very rare (HP:0040284). (ORPHA:2583)
- Paraplegia (HP:0010550): Severe or complete weakness of both lower extremities with sparing of the upper extremities. Evidence: TAS. Frequency: Very rare (HP:0040284). (ORPHA:2583)
- Bone cyst (HP:0012062): A fluid filled cavity that develops with a bone. Evidence: TAS. Frequency: Very rare (HP:0040284). (ORPHA:2583)
- Abdominal mass (HP:0031500): An abnormal enlargement or swelling in the abdomen. Evidence: TAS. Frequency: Very rare (HP:0040284). (ORPHA:2583)
- Pelvic mass (HP:0031501): An abnormal enlargement or swelling in the pelvic region. Evidence: TAS. Frequency: Very rare (HP:0040284). (ORPHA:2583)
- Scalp tenderness (HP:0100809): Pain or discomfort of the scalp elicited by palpation. Evidence: TAS. Frequency: Very rare (HP:0040284). (ORPHA:2583)